Phenotypes associated with the disease spermatogenic failure 39 (OMIM:618643):
- Coiled sperm flagella (HP:0032560): Sperm cells whose flagella are twisted (coiled). Evidence: PCS. (PMID:31178125)
- Male infertility (HP:0003251). Evidence: PCS. Frequency: 5/5. (PMID:31178125)
- Young adult onset (HP:0011462): Onset of disease at the age of between 16 and 40 years. Evidence: PCS. Frequency: 5/5. (PMID:31178125)
- Tapered sperm head (HP:0032562): Sperm with cigar-shaped heads that gradually dimish in diameter (taper). Evidence: PCS. (PMID:31178125)
- Autosomal recessive inheritance (HP:0000007): A mode of inheritance that is observed for traits related to a gene encoded on one of the autosomes (i.e., the human chromosomes 1-22) in which a trait manifests in individuals with two pathogenic alleles, either homozygotes (two copies of the same mutant allele) or compound heterozygotes (whereby each copy of a gene has a distinct mutant allele). Evidence: PCS. (PMID:31178125)
- Reduced sperm motility (HP:0012207): An abnormal reduction in the mobility of ejaculated sperm. Evidence: PCS. Frequency: 15/15. (PMID:31178125)
- Absent sperm flagella (HP:0032558): Sperm cells lacking flagella. Evidence: PCS. (PMID:31178125)
- Oligozoospermia (HP:0000798): Reduced count of spermatozoa in the semen, defined as a sperm count below 20 million per milliliter semen. Evidence: PCS. (PMID:31178125)
- Short sperm flagella (HP:0032559): Sperm cells with abnormally short flagella. Evidence: PCS. (PMID:31178125)